Phenotypes associated with the disease Gabriele-de Vries syndrome (ORPHA:506358):
- Thick lower lip vermilion (HP:0000179): Increased thickness of the lower lip, leading to a prominent appearance of the lower lip. The height of the vermilion of the lower lip in the midline is more than 2 SD above the mean. Alternatively, an apparently increased height of the vermilion of the lower lip in the frontal view (subjective). Evidence: TAS. Frequency: Very frequent (HP:0040281). (ORPHA:506358)
- Malar flattening (HP:0000272): Underdevelopment of the malar prominence of the jugal bone (zygomatic bone in mammals), appreciated in profile, frontal view, and/or by palpation. Evidence: TAS. Frequency: Very frequent (HP:0040281). (ORPHA:506358)
- Broad forehead (HP:0000337): Width of the forehead or distance between the frontotemporales is more than two standard deviations above the mean (objective); or apparently increased distance between the two sides of the forehead. Evidence: TAS. Frequency: Very frequent (HP:0040281). (ORPHA:506358)
- Bulbous nose (HP:0000414): Increased volume and globular shape of the anteroinferior aspect of the nose. Evidence: TAS. Frequency: Very frequent (HP:0040281). (ORPHA:506358)
- Global developmental delay (HP:0001263): A delay in the achievement of motor or mental milestones in the domains of development of a child, including motor skills, speech and language, cognitive skills, and social and emotional skills. This term should only be used to describe children younger than five years of age. Evidence: TAS. Frequency: Very frequent (HP:0040281). (ORPHA:506358)
- Abnormal facial shape (HP:0001999): An abnormal morphology (form) of the face or its components. Evidence: TAS. Frequency: Very frequent (HP:0040281). (ORPHA:506358)
- Pointed chin (HP:0000307): A marked tapering of the lower face to the chin. Evidence: TAS. Frequency: Frequent (HP:0040282). (ORPHA:506358)
- Facial asymmetry (HP:0000324): An abnormal difference between the left and right sides of the face. Evidence: TAS. Frequency: Frequent (HP:0040282). (ORPHA:506358)
- Posteriorly rotated ears (HP:0000358): A type of abnormal location of the ears in which the position of the ears is characterized by posterior rotation (the superior part of the ears is rotated towards the back of the head, and the inferior part of the ears towards the front). Evidence: TAS. Frequency: Frequent (HP:0040282). (ORPHA:506358)
- Strabismus (HP:0000486): A misalignment of the eyes so that the visual axes deviate from bifoveal fixation. The classification of strabismus may be based on a number of features including the relative position of the eyes, whether the deviation is latent or manifest, intermittent or constant, concomitant or otherwise and according to the age of onset and the relevance of any associated refractive error. Evidence: TAS. Frequency: Frequent (HP:0040282). (ORPHA:506358)
- Downslanted palpebral fissures (HP:0000494): The palpebral fissure inclination is more than two standard deviations below the mean. Evidence: TAS. Frequency: Frequent (HP:0040282). (ORPHA:506358)
- Periorbital fullness (HP:0000629): Increase in periorbital soft tissue. Evidence: TAS. Frequency: Frequent (HP:0040282). (ORPHA:506358)
- Atypical behavior (HP:0000708): Atypical behavior is an abnormality in a person's actions that can be controlled or modulated by the will of the individual. While abnormal behaviors can be difficult to control, they are distinct from other abnormal actions that cannot be affected by the individual's will. Evidence: TAS. Frequency: Frequent (HP:0040282). (ORPHA:506358)
- Delayed speech and language development (HP:0000750): A degree of language development that is significantly below the norm for a child of a specified age. Evidence: TAS. Frequency: Frequent (HP:0040282). (ORPHA:506358)
- Hypotonia (HP:0001252): Hypotonia is an abnormally low muscle tone (the amount of tension or resistance to movement in a muscle). Even when relaxed, muscles have a continuous and passive partial contraction which provides some resistance to passive stretching. Hypotonia thus manifests as diminished resistance to passive stretching. Hypotonia is not the same as muscle weakness, although the two conditions can co-exist. Evidence: TAS. Frequency: Frequent (HP:0040282). (ORPHA:506358)
- Mild intellectual disability (HP:0001256): Mild intellectual disability (ID) is defined as a type of ID characterized by mildly sub-average adaptive functioning and intellectual functioning, with an intelligence quotient (IQ) the range of 50-69. Evidence: TAS. Frequency: Frequent (HP:0040282). (ORPHA:506358)
- Intrauterine growth retardation (HP:0001511): An abnormal restriction of fetal growth with fetal weight below the tenth percentile for gestational age. Evidence: TAS. Frequency: Frequent (HP:0040282). (ORPHA:506358)
- Moderate intellectual disability (HP:0002342): Moderate intellectual disability (ID) is defined as a type of ID characterized by moderately sub-average adaptive functioning and intellectual functioning, with an intelligence quotient (IQ) the range of 35-49. Evidence: TAS. Frequency: Frequent (HP:0040282). (ORPHA:506358)
- Feeding difficulties in infancy (HP:0008872): Impaired feeding performance of an infant as manifested by difficulties such as weak and ineffective sucking, brief bursts of sucking, and falling asleep during sucking. There may be difficulties with chewing or maintaining attention. Evidence: TAS. Frequency: Frequent (HP:0040282). (ORPHA:506358)
- Abnormality of upper lip vermillion (HP:0011339): An abnormality of the vermilion border, the sharp demarcation between the lip (red colored) and the adjacent normal skin. Evidence: TAS. Frequency: Frequent (HP:0040282). (ORPHA:506358)
- Gastrostomy tube feeding in infancy (HP:0011471): Feeding problem necessitating gastrostomy tube feeding. Evidence: TAS. Frequency: Frequent (HP:0040282). (ORPHA:506358)
- Delayed ability to walk (HP:0031936): A failure to achieve the ability to walk at an appropriate developmental stage. Most children learn to walk in a series of stages, and learn to walk short distances independently between 12 and 15 months. Evidence: TAS. Frequency: Frequent (HP:0040282). (ORPHA:506358)
- Oral-pharyngeal dysphagia (HP:0200136). Evidence: TAS. Frequency: Frequent (HP:0040282). (ORPHA:506358)
- Cryptorchidism (HP:0000028): Testis in inguinal canal. That is, absence of one or both testes from the scrotum owing to failure of the testis or testes to descend through the inguinal canal to the scrotum. Evidence: TAS. Frequency: Occasional (HP:0040283). (ORPHA:506358)
- Ureteropelvic junction obstruction (HP:0000074): Blockage of urine flow from the renal pelvis to the proximal ureter. Evidence: TAS. Frequency: Occasional (HP:0040283). (ORPHA:506358)
- Hydronephrosis (HP:0000126): Severe distention of the kidney with dilation of the renal pelvis and calices. Evidence: TAS. Frequency: Occasional (HP:0040283). (ORPHA:506358)
- Abnormality of the dentition (HP:0000164): Any abnormality of the teeth. Evidence: TAS. Frequency: Occasional (HP:0040283). (ORPHA:506358)
- High palate (HP:0000218): Height of the palate more than 2 SD above the mean (objective) or palatal height at the level of the first permanent molar more than twice the height of the teeth (subjective). Evidence: TAS. Frequency: Occasional (HP:0040283). (ORPHA:506358)
- Dolichocephaly (HP:0000268): An abnormality of skull shape characterized by a increased anterior-posterior diameter, i.e., an increased antero-posterior dimension of the skull. Cephalic index less than 76%. Alternatively, an apparently increased antero-posterior length of the head compared to width. Often due to premature closure of the sagittal suture. Evidence: TAS. Frequency: Occasional (HP:0040283). (ORPHA:506358)
- Facial hypotonia (HP:0000297): Reduced muscle tone of a muscle that is innervated by the facial nerve (the seventh cranial nerve). Evidence: TAS. Frequency: Occasional (HP:0040283). (ORPHA:506358)
- Micrognathia (HP:0000347): Developmental hypoplasia of the mandible. Evidence: TAS. Frequency: Occasional (HP:0040283). (ORPHA:506358)
- Low-set ears (HP:0000369): Upper insertion of the ear to the scalp below an imaginary horizontal line drawn between the inner canthi of the eye and extending posteriorly to the ear. Evidence: TAS. Frequency: Occasional (HP:0040283). (ORPHA:506358)
- Astigmatism (HP:0000483): A type of refraction error associated with abnormal curvatures on the anterior and/or posterior surface of the cornea. Evidence: TAS. Frequency: Occasional (HP:0040283). (ORPHA:506358)
- Telecanthus (HP:0000506): Distance between the inner canthi more than two standard deviations above the mean (objective); or, apparently increased distance between the inner canthi. Evidence: TAS. Frequency: Occasional (HP:0040283). (ORPHA:506358)
- Ptosis (HP:0000508): The upper eyelid margin is positioned 3 mm or more lower than usual and covers the superior portion of the iris (objective); or, the upper lid margin obscures at least part of the pupil (subjective). Evidence: TAS. Frequency: Occasional (HP:0040283). (ORPHA:506358)
- Hypermetropia (HP:0000540): An abnormality of refraction characterized by the ability to see objects in the distance clearly, while objects nearby appear blurry. Evidence: TAS. Frequency: Occasional (HP:0040283). (ORPHA:506358)
- Autism (HP:0000717): Autism is a neurodevelopmental disorder characterized by impaired social interaction and communication, and by restricted and repetitive behavior. Autism begins in childhood. It is marked by the presence of markedly abnormal or impaired development in social interaction and communication and a markedly restricted repertoire of activity and interest. Manifestations of the disorder vary greatly depending on the developmental level and chronological age of the individual (DSM-IV). Evidence: TAS. Frequency: Occasional (HP:0040283). (ORPHA:506358)
- Autistic behavior (HP:0000729): Persistent deficits in social interaction and communication and interaction as well as a markedly restricted repertoire of activity and interest as well as repetitive patterns of behavior. Evidence: TAS. Frequency: Occasional (HP:0040283). (ORPHA:506358)
- Anxiety (HP:0000739): Intense feelings of nervousness, tension, or panic often arise in response to interpersonal stresses. There is worry about the negative effects of past unpleasant experiences and future negative possibilities. Individuals may feel fearful, apprehensive, or threatened by uncertainty, and they may also have fears of falling apart or losing control. Evidence: TAS. Frequency: Occasional (HP:0040283). (ORPHA:506358)
- Hypothyroidism (HP:0000821): Deficiency of thyroid hormone. Evidence: TAS. Frequency: Occasional (HP:0040283). (ORPHA:506358)
- Decreased response to growth hormone stimulation test (HP:0000824): Insufficient responses to growth hormone (GH) provocation tests. GH deficiency is defined as a serum peak GH concentration less than 10 ng/mL on provocation with a combination of at least two separate stimulation tests. Evidence: TAS. Frequency: Occasional (HP:0040283). (ORPHA:506358)
- Hyperextensible skin (HP:0000974): A condition in which the skin can be stretched beyond normal, and then returns to its initial position. Evidence: TAS. Frequency: Occasional (HP:0040283). (ORPHA:506358)
- Agenesis of corpus callosum (HP:0001274): Absence of the corpus callosum as a result of the failure of the corpus callosum to develop, which can be the result of a failure in any one of the multiple steps of callosal development including cellular proliferation and migration, axonal growth or glial patterning at the midline. Evidence: TAS. Frequency: Occasional (HP:0040283). (ORPHA:506358)
- Dystonia (HP:0001332): An abnormally increased muscular tone that causes fixed abnormal postures. There is a slow, intermittent twisting motion that leads to exaggerated turning and posture of the extremities and trunk. Evidence: TAS. Frequency: Occasional (HP:0040283). (ORPHA:506358)
- Tremor (HP:0001337): An unintentional, oscillating to-and-fro muscle movement about a joint axis. Evidence: TAS. Frequency: Occasional (HP:0040283). (ORPHA:506358)
- Absent speech (HP:0001344): Complete lack of development of speech and language abilities. Evidence: TAS. Frequency: Occasional (HP:0040283). (ORPHA:506358)
- Craniosynostosis (HP:0001363): Craniosynostosis refers to the premature closure of the cranial sutures. Primary craniosynostosis refers to the closure of one or more sutures due to abnormalities in skull development, and secondary craniosynostosis results from failure of brain growth. Evidence: TAS. Frequency: Occasional (HP:0040283). (ORPHA:506358)
- Small for gestational age (HP:0001518): Smaller than normal size according to sex and gestational age related norms, defined as a weight below the 10th percentile for the gestational age. Evidence: TAS. Frequency: Occasional (HP:0040283). (ORPHA:506358)
- Patent foramen ovale (HP:0001655): Failure of the foramen ovale to seal postnatally, leaving a potential conduit between the left and right cardiac atria. Evidence: TAS. Frequency: Occasional (HP:0040283). (ORPHA:506358)
- Hallux valgus (HP:0001822): Lateral deviation of the great toe (i.e., in the direction of the little toe). Evidence: TAS. Frequency: Occasional (HP:0040283). (ORPHA:506358)
- Sandal gap (HP:0001852): A widely spaced gap between the first toe (the great toe) and the second toe. Evidence: TAS. Frequency: Occasional (HP:0040283). (ORPHA:506358)
- Esophageal atresia (HP:0002032): A developmental defect resulting in complete obliteration of the lumen of the esophagus such that the esophagus ends in a blind pouch rather than connecting to the stomach. Evidence: TAS. Frequency: Occasional (HP:0040283). (ORPHA:506358)
- Hypoplasia of the corpus callosum (HP:0002079): Underdevelopment of the corpus callosum. Evidence: TAS. Frequency: Occasional (HP:0040283). (ORPHA:506358)
- Ventriculomegaly (HP:0002119): An increase in size of the ventricular system of the brain. Evidence: TAS. Frequency: Occasional (HP:0040283). (ORPHA:506358)
- Gliosis (HP:0002171): Gliosis is the focal proliferation of glial cells in the central nervous system. Evidence: TAS. Frequency: Occasional (HP:0040283). (ORPHA:506358)
- Frontal upsweep of hair (HP:0002236): Upward and/or sideward growth of anterior hair. Evidence: TAS. Frequency: Occasional (HP:0040283). (ORPHA:506358)
- Abnormal cerebral white matter morphology (HP:0002500): An abnormality of the cerebral white matter. Evidence: TAS. Frequency: Occasional (HP:0040283). (ORPHA:506358)
- Waddling gait (HP:0002515): Weakness of the hip girdle and upper thigh muscles, for instance in myopathies, leads to an instability of the pelvis on standing and walking. If the muscles extending the hip joint are affected, the posture in that joint becomes flexed and lumbar lordosis increases. The patients usually have difficulties standing up from a sitting position. Due to weakness in the gluteus medius muscle, the hip on the side of the swinging leg drops with each step (referred to as Trendelenburg sign). The gait appears waddling. The patients frequently attempt to counteract the dropping of the hip on the swinging side by bending the trunk towards the side which is in the stance phase (in the German language literature this is referred to as Duchenne sign). Similar gait patterns can be caused by orthopedic conditions when the origin and the insertion site of the gluteus medius muscle are closer to each other than normal, for instance due to a posttraumatic elevation of the trochanter or pseudarthrosis of the femoral neck. Evidence: TAS. Frequency: Occasional (HP:0040283). (ORPHA:506358)
- Recurrent infections (HP:0002719): Increased susceptibility to infections as manifested by repeated bouts of infection. Evidence: TAS. Frequency: Occasional (HP:0040283). (ORPHA:506358)
- Neuroblastoma (HP:0003006): Neuroblastoma is a solid tumor that originate in neural crest cells of the sympathetic nervous system. Most neuroblastomas originate in the abdomen, and most abdominal neuroblastomas originate in the adrenal gland. Neuroblastomas can also originate in the thorax, usually in the posterior mediastinum. Evidence: TAS. Frequency: Occasional (HP:0040283). (ORPHA:506358)
- Breast hypoplasia (HP:0003187): Underdevelopment of the breast. Evidence: TAS. Frequency: Occasional (HP:0040283). (ORPHA:506358)
- Distal arthrogryposis (HP:0005684): An inherited primary limb malformation disorder characterized by congenital contractures of two or more different body areas and without primary neurologic and/or muscle disease that affects limb function. Evidence: TAS. Frequency: Occasional (HP:0040283). (ORPHA:506358)
- Finger joint hypermobility (HP:0006094). Evidence: TAS. Frequency: Occasional (HP:0040283). (ORPHA:506358)
- Attention deficit hyperactivity disorder (HP:0007018): Attention deficit hyperactivity disorder (ADHD) manifests at age 2-3 years or by first grade at the latest. The main symptoms are distractibility, impulsivity, hyperactivity, and often trouble organizing tasks and projects, difficulty going to sleep, and social problems from being aggressive, loud, or impatient. Evidence: TAS. Frequency: Occasional (HP:0040283). (ORPHA:506358)
- Lacrimal duct stenosis (HP:0007678): Narrowing of a tear duct (lacrimal duct). Evidence: TAS. Frequency: Occasional (HP:0040283). (ORPHA:506358)
- Distal lower limb amyotrophy (HP:0008944): Muscular atrophy of distal leg muscles. Evidence: TAS. Frequency: Occasional (HP:0040283). (ORPHA:506358)
- Ebstein anomaly of the tricuspid valve (HP:0010316): Ebstein's anomaly refers to an abnormally placed and deformed tricuspid valve characterized by apical displacement of the septal and posterior tricuspid valve leaflets, leading to atrialization of the right ventricle with a variable degree of malformation and displacement of the anterior leaflet. Evidence: TAS. Frequency: Occasional (HP:0040283). (ORPHA:506358)
- Patellar subluxation (HP:0010499): The kneecap normally is located within the groove termed trochlea on the distal femur and can slide up and down in it. Patellar subluxation refers to an unstable kneecap that does not slide centrally within its groove, i.e., a partial dislocation of the patella. Evidence: TAS. Frequency: Occasional (HP:0040283). (ORPHA:506358)
- Severe intellectual disability (HP:0010864): Severe intellectual disability (ID) is defined as a type of ID characterized by severely sub-average adaptive functioning and intellectual functioning, with an intelligence quotient (IQ) the range of 20-34. Evidence: TAS. Frequency: Occasional (HP:0040283). (ORPHA:506358)
- Sydney crease (HP:0011311): Extension of the proximal transverse crease (five finger crease) to the ulnar edge of the palm. Evidence: TAS. Frequency: Occasional (HP:0040283). (ORPHA:506358)
- Severe global developmental delay (HP:0011344): A severe delay in the achievement of motor or mental milestones in the domains of development of a child. Evidence: TAS. Frequency: Occasional (HP:0040283). (ORPHA:506358)
- Delayed myelination (HP:0012448): Delayed myelination. Evidence: TAS. Frequency: Occasional (HP:0040283). (ORPHA:506358)
- Sparse eyebrow (HP:0045075): Decreased density/number of eyebrow hairs. Evidence: TAS. Frequency: Occasional (HP:0040283). (ORPHA:506358)